Phenotypes associated with the disease Ablepharon macrostomia syndrome (ORPHA:920):
- Abnormal female external genitalia morphology (HP:0000055): Any structural abnormality of the female external genitalia. Evidence: TAS. Frequency: Frequent (HP:0040282). (ORPHA:920)
- Ambiguous genitalia (HP:0000062): A genital phenotype that is not clearly assignable to a single gender. Ambiguous genitalia can be evaluated using the Prader scale: Prader 0: Normal female external genitalia. Prader 1: Female external genitalia with clitoromegaly. Prader 2: Clitoromegaly with partial labial fusion forming a funnel-shaped urogenital sinus. Prader 3: Increased phallic enlargement. Complete labioscrotal fusion forming a urogenital sinus with a single opening. Prader 4: Complete scrotal fusion with urogenital opening at the base or on the shaft of the phallus. Prader 5: Normal male external genitalia. The diagnosis of ambiguous genitalia is made for Prader 1-4. Evidence: TAS. Frequency: Frequent (HP:0040282). (ORPHA:920)
- Wide mouth (HP:0000154): Distance between the oral commissures more than 2 SD above the mean. Alternatively, an apparently increased width of the oral aperture (subjective). Evidence: TAS. Frequency: Very frequent (HP:0040281). (ORPHA:920)
- Thin vermilion border (HP:0000233): Height of the vermilion of the medial part of the lip more than 2 SD below the mean, or apparently reduced height of the vermilion of the lip in the frontal view. The vermilion is the red part of the lips (and confusingly, the vermilion itself is also often referred to as being equivalent the lips). Evidence: TAS. Frequency: Occasional (HP:0040283). (ORPHA:920)
- Hypoplasia of the maxilla (HP:0000327): Abnormally small dimension of the Maxilla. Usually creating a malocclusion or malalignment between the upper and lower teeth or resulting in a deficient amount of projection of the base of the nose and lower midface region. Evidence: TAS. Frequency: Frequent (HP:0040282). (ORPHA:920)
- Hearing impairment (HP:0000365): A decreased magnitude of the sensory perception of sound. Evidence: TAS. Frequency: Frequent (HP:0040282). (ORPHA:920)
- Atresia of the external auditory canal (HP:0000413): Absence or failure to form of the external auditory canal. Evidence: TAS. Frequency: Occasional (HP:0040283). (ORPHA:920)
- Underdeveloped nasal alae (HP:0000430): Thinned, deficient, or excessively arched ala nasi. Evidence: TAS. Frequency: Very frequent (HP:0040281). (ORPHA:920)
- Anteverted nares (HP:0000463): Anteriorly-facing nostrils viewed with the head in the Frankfurt horizontal and the eyes of the observer level with the eyes of the subject. This gives the appearance of an upturned nose (upturned nasal tip). Evidence: TAS. Frequency: Frequent (HP:0040282). (ORPHA:920)
- Visual impairment (HP:0000505): Visual impairment (or vision impairment) is vision loss (of a person) to such a degree as to qualify as an additional support need through a significant limitation of visual capability resulting from either disease, trauma, or congenital or degenerative conditions that cannot be corrected by conventional means, such as refractive correction, medication, or surgery. Evidence: TAS. Frequency: Frequent (HP:0040282). (ORPHA:920)
- Myopia (HP:0000545): An abnormality of refraction characterized by the ability to see objects nearby clearly, while objects in the distance appear blurry. Evidence: TAS. Frequency: Frequent (HP:0040282). (ORPHA:920)
- Absent eyelashes (HP:0000561): Lack of eyelashes. Evidence: TAS. Frequency: Very frequent (HP:0040281). (ORPHA:920)
- Microdontia (HP:0000691): Decreased size of the teeth, which can be defined as a mesiodistal tooth diameter (width) more than 2 SD below mean. Alternatively, an apparently decreased maximum width of tooth. Evidence: TAS. Frequency: Frequent (HP:0040282). (ORPHA:920)
- Delayed speech and language development (HP:0000750): A degree of language development that is significantly below the norm for a child of a specified age. Evidence: TAS. Frequency: Very frequent (HP:0040281). (ORPHA:920)
- Dry skin (HP:0000958): Skin characterized by the lack of natural or normal moisture. Evidence: TAS. Frequency: Frequent (HP:0040282). (ORPHA:920)
- Thin skin (HP:0000963): Reduction in thickness of the skin, generally associated with a loss of suppleness and elasticity of the skin. Evidence: TAS. Frequency: Frequent (HP:0040282). (ORPHA:920)
- Abnormal skin pigmentation (HP:0001000): An abnormality of the pigmentation of the skin. Evidence: TAS. Frequency: Occasional (HP:0040283). (ORPHA:920)
- Cryptophthalmos (HP:0001126): Cryptophthalmos is a condition of total absence of eyelids and the skin of forehead is continuous with that of cheek, in which the eyeball is completely concealed by the skin, which is stretched over the orbital cavity. Evidence: TAS. Frequency: Frequent (HP:0040282). (ORPHA:920)
- Global developmental delay (HP:0001263): A delay in the achievement of motor or mental milestones in the domains of development of a child, including motor skills, speech and language, cognitive skills, and social and emotional skills. This term should only be used to describe children younger than five years of age. Evidence: TAS. Frequency: Frequent (HP:0040282). (ORPHA:920)
- Growth delay (HP:0001510): A deficiency or slowing down of growth pre- and postnatally. Evidence: TAS. Frequency: Occasional (HP:0040283). (ORPHA:920)
- Umbilical hernia (HP:0001537): Protrusion of abdominal contents through a defect in the abdominal wall musculature around the umbilicus. Skin and subcutaneous tissue overlie the defect. Evidence: TAS. Frequency: Frequent (HP:0040282). (ORPHA:920)
- Omphalocele (HP:0001539): A midline anterior incomplete closure of the abdominal wall in which there is herniation of the abdominal viscera into the base of the abdominal cord. Evidence: TAS. Frequency: Occasional (HP:0040283). (ORPHA:920)
- Redundant skin (HP:0001582): Loose and sagging skin often associated with loss of skin elasticity. Evidence: TAS. Frequency: Very frequent (HP:0040281). (ORPHA:920)
- Toe syndactyly (HP:0001770): Webbing or fusion of the toes, involving soft parts only or including bone structure. Bony fusions are referred to as "bony" Syndactyly if the fusion occurs in a radio-ulnar axis. Fusions of bones of the toes in a proximo-distal axis are referred to as "Symphalangism". Evidence: TAS. Frequency: Occasional (HP:0040283). (ORPHA:920)
- Fine hair (HP:0002213): Hair that is fine or thin to the touch. Evidence: TAS. Frequency: Very frequent (HP:0040281). (ORPHA:920)
- Absent eyebrow (HP:0002223): Absence of the eyebrow. Evidence: TAS. Frequency: Very frequent (HP:0040281). (ORPHA:920)
- Breast hypoplasia (HP:0003187): Underdevelopment of the breast. Evidence: TAS. Frequency: Frequent (HP:0040282). (ORPHA:920)
- Depressed nasal bridge (HP:0005280): Posterior positioning of the nasal root in relation to the overall facial profile for age. Evidence: TAS. Frequency: Occasional (HP:0040283). (ORPHA:920)
- Aplasia/Hypoplasia of the nipples (HP:0006709). Evidence: TAS. Frequency: Frequent (HP:0040282). (ORPHA:920)
- Excessive wrinkled skin (HP:0007392). Evidence: TAS. Frequency: Frequent (HP:0040282). (ORPHA:920)
- Corneal opacity (HP:0007957): A reduction of corneal clarity. Evidence: TAS. Frequency: Frequent (HP:0040282). (ORPHA:920)
- Sparse hair (HP:0008070): Reduced density of hairs. Evidence: TAS. Frequency: Very frequent (HP:0040281). (ORPHA:920)
- Microtia (HP:0008551): Underdevelopment of the external ear. Evidence: TAS. Frequency: Very frequent (HP:0040281). (ORPHA:920)
- Hypoplasia of penis (HP:0008736). Evidence: TAS. Frequency: Frequent (HP:0040282). (ORPHA:920)
- Hypoplasia of the zygomatic bone (HP:0010669): Underdevelopment of the zygomatic bone. That is, a reduction in size of the zygomatic bone, including the zygomatic process of the temporal bone of the skull, which forms part of the zygomatic arch. Evidence: TAS. Frequency: Very frequent (HP:0040281). (ORPHA:920)
- Abnormal hair pattern (HP:0010720): An abnormality of the distribution of hair growth. Evidence: TAS. Frequency: Occasional (HP:0040283). (ORPHA:920)
- Ablepharon (HP:0011224): Absent eyelids. Evidence: TAS. Frequency: Very frequent (HP:0040281). (ORPHA:920)
- Camptodactyly of finger (HP:0100490): The distal interphalangeal joint and/or the proximal interphalangeal joint of the fingers cannot be extended to 180 degrees by either active or passive extension. Evidence: TAS. Frequency: Frequent (HP:0040282). (ORPHA:920)
- Corneal erosion (HP:0200020): An erosion or abrasion of the cornea's outermost layer of epithelial cells. Evidence: TAS. Frequency: Occasional (HP:0040283). (ORPHA:920)